Phenotypes associated with the disease Craniodiaphyseal dysplasia (ORPHA:1513):
- Macrocephaly (HP:0000256): Occipitofrontal (head) circumference greater than 97th centile compared to appropriate, age matched, sex-matched normal standards. Alternatively, a apparently increased size of the cranium. Evidence: TAS. Frequency: Very frequent (HP:0040281). (ORPHA:1513)
- Coarse facial features (HP:0000280): Absence of fine and sharp appearance of brows, nose, lips, mouth, and chin, usually because of rounded and heavy features or thickened skin with or without thickening of subcutaneous and bony tissues. Evidence: TAS. Frequency: Very frequent (HP:0040281). (ORPHA:1513)
- Stenosis of the external auditory canal (HP:0000402): An abnormal narrowing of the external auditory canal. Evidence: TAS. Frequency: Frequent (HP:0040282). (ORPHA:1513)
- Conductive hearing impairment (HP:0000405): An abnormality of vibrational conductance of sound to the inner ear leading to impairment of sensory perception of sound. Evidence: TAS. Frequency: Frequent (HP:0040282). (ORPHA:1513)
- Wide nasal bridge (HP:0000431): Increased breadth of the nasal bridge (and with it, the nasal root). Evidence: TAS. Frequency: Very frequent (HP:0040281). (ORPHA:1513)
- Optic atrophy (HP:0000648): Atrophy of the optic nerve. Optic atrophy results from the death of the retinal ganglion cell axons that comprise the optic nerve and manifesting as a pale optic nerve on fundoscopy. Evidence: TAS. Frequency: Occasional (HP:0040283). (ORPHA:1513)
- Abnormal rib morphology (HP:0000772): An anomaly of the rib. Evidence: TAS. Frequency: Very frequent (HP:0040281). (ORPHA:1513)
- Intellectual disability (HP:0001249): The term intellectual disability or intellectual developmental disorder is used to describe significantly sub-average intellectual and adaptive functioning based on clinical assessment and as measured by individually administered, appropriately normed, standardized and validated tests of intellectual functioning and adaptive behavior, with onset during the developmental period from infancy through adolescence. Evidence: TAS. Frequency: Very frequent (HP:0040281). (ORPHA:1513)
- Frontal bossing (HP:0002007): Bilateral bulging of the lateral frontal bone prominences with relative sparing of the midline. Evidence: TAS. Frequency: Very frequent (HP:0040281). (ORPHA:1513)
- Short stature (HP:0004322): A height below that which is expected according to age and gender norms. Although there is no universally accepted definition of short stature, many refer to "short stature" as height more than 2 standard deviations below the mean for age and gender (or below the 3rd percentile for age and gender dependent norms). Evidence: TAS. Frequency: Very frequent (HP:0040281). (ORPHA:1513)
- Craniofacial hyperostosis (HP:0004493): Excessive growth of the craniofacial bones. Evidence: TAS. Frequency: Very frequent (HP:0040281). (ORPHA:1513)
- Diaphyseal undertubulation (HP:0005019): Tubulation refers to the size and shape of tubular bones. In children and adolescents, the modeling process regulates normal bone growth. Final shaft (tube) diameter depends on appositional bone growth and the equilibrium between periosteal and endosteal bone resorption and formation. Undertubulation refers to a broad, widened form of the shafts (diaphyses) of long bones. Evidence: TAS. Frequency: Very frequent (HP:0040281). (ORPHA:1513)
- Depressed nasal bridge (HP:0005280): Posterior positioning of the nasal root in relation to the overall facial profile for age. Evidence: TAS. Frequency: Very frequent (HP:0040281). (ORPHA:1513)